Phenotypes associated with the disease retinitis pigmentosa 57 (OMIM:613582):
- Constriction of peripheral visual field (HP:0001133): An absolute or relative decrease in retinal sensitivity extending from edge (periphery) of the visual field in a concentric pattern. The visual field is the area that is perceived simultaneously by a fixating eye. Evidence: PCS. Frequency: 4/4. (PMID:20655036)
- Spicular pigmentation of the retina (HP:0007737): Pigment migration into the retina in a bone-spicule configuration (resembling the nucleated cells within the lacuna of bone). Evidence: PCS. (PMID:20655036)
- Childhood onset (HP:0011463): Onset of disease at the age of between 1 and 5 years. Evidence: PCS. (PMID:20655036)
- Autosomal recessive inheritance (HP:0000007): A mode of inheritance that is observed for traits related to a gene encoded on one of the autosomes (i.e., the human chromosomes 1-22) in which a trait manifests in individuals with two pathogenic alleles, either homozygotes (two copies of the same mutant allele) or compound heterozygotes (whereby each copy of a gene has a distinct mutant allele). Evidence: PCS. (PMID:20655036)
- Reduced visual acuity (HP:0007663). Evidence: PCS. Frequency: 6/6. (PMID:20655036)
- Cystoid macular edema (HP:0011505): Cystoid thickening of the retina that takes place due to accumulation of extracellular fluid in the macula as a nonspecific response to blood-retinal barrier breakdown. Histological studies show that radially orientated cystoid spaces consisting of ophthalmoscopically clear fluid are often clinically detectable in the macula area. Evidence: PCS. (PMID:20655036)
- Optic disc pallor (HP:0000543): A pale yellow discoloration of the optic disc (the area of the optic nerve head in the retina). The optic disc normally has a pinkish hue with a central yellowish depression. Evidence: PCS. Onset: Young adult onset (HP:0011462). (PMID:20655036)
- Rod-cone dystrophy (HP:0000510): An inherited retinal disease subtype in which the rod photoreceptors appear to be more severely affected than the cone photoreceptors. Typical presentation is with nyctalopia (due to rod dysfunction) followed by loss of mid-peripheral field of vision, which gradually extends and leaves many patients with a small central island of vision due to the preservation of macular cones. Evidence: PCS. (PMID:20655036)
- Absent foveal reflex (HP:0030825): Absent reflectivity of the fovea, which normally is a bright pinpoint of light that is observed to move sideways or up and down in response to movement of the opthalmoscope. Evidence: PCS. (PMID:20655036)
- Attenuation of retinal blood vessels (HP:0007843): Narrowing of the retinal blood vessels, both arterioles and venules. Evidence: PCS. Onset: Young adult onset (HP:0011462). (PMID:20655036)